- Elevated erythrocyte sedimentation rate (HP:0003565): An increased erythrocyte sedimentation rate (ESR). The ESR is a test that measures the distance that erythrocytes have fallen after one hour in a vertical column of anticoagulated blood under the influence of gravity. The ESR is a nonspecific finding. An elevation may indicate inflammation or may be caused by any condition that elevates fibrinogen. Evidence: TAS. Frequency: Very frequent (HP:0040281). (ORPHA:411703)
- Bronchiectasis (HP:0002110): Persistent abnormal dilatation of the bronchi owing to localized and irreversible destruction and widening of the large airways. Evidence: TAS. Frequency: Frequent (HP:0040282). (ORPHA:411703)
- Cough (HP:0012735): A sudden, audible expulsion of air from the lungs through a partially closed glottis, preceded by inhalation. Evidence: TAS. Frequency: Frequent (HP:0040282). (ORPHA:411703)
- Asthenia (HP:0025406): A state characterized by a feeling of weakness and loss of strength leading to a generalized weakness of the body. Evidence: TAS. Frequency: Frequent (HP:0040282). (ORPHA:411703)
- Pulmonary opacity (HP:0031457): Opacity refers to any area that preferentially attenuates the x-ray beam and therefore appears more opaque than the surrounding area. It is a nonspecific term that does not indicate the size or pathologic nature of the abnormality. Evidence: TAS. Frequency: Frequent (HP:0040282). (ORPHA:411703)
- Abnormal sputum (HP:0032016): Abnormal appearance of material expectorated (coughed up) from the respiratory system and that is composed of mucus but may contain other substances such as pus, blood, microorganisms, and fibrin. Evidence: TAS. Frequency: Frequent (HP:0040282). (ORPHA:411703)
- Pericardial effusion (HP:0001698): Accumulation of fluid within the pericardium. Evidence: TAS. Frequency: Occasional (HP:0040283). (ORPHA:411703)
- Weight loss (HP:0001824): Reduction of total body weight. Evidence: TAS. Frequency: Occasional (HP:0040283). (ORPHA:411703)
- Fever (HP:0001945): Body temperature elevated above the normal range. Evidence: TAS. Frequency: Occasional (HP:0040283). (ORPHA:411703)
- Diarrhea (HP:0002014): Abnormally increased frequency (usually defined as three or more) loose or watery bowel movements a day. Evidence: TAS. Frequency: Occasional (HP:0040283). (ORPHA:411703)
- Dyspnea (HP:0002094): Difficult or labored breathing. Dyspnea is a subjective feeling only the patient can rate, e.g., on a Borg scale. Evidence: TAS. Frequency: Occasional (HP:0040283). (ORPHA:411703)
- Respiratory distress (HP:0002098): Respiratory distress is objectively observable as the physical or emotional consequences from the experience of dyspnea. The physical presentation of respiratory distress is generally referred to as labored breathing, while the sensation of respiratory distress is called shortness of breath or dyspnea. Evidence: TAS. Frequency: Occasional (HP:0040283). (ORPHA:411703)
- Hemoptysis (HP:0002105): Coughing up (expectoration) of blood or blood-streaked sputum from the larynx, trachea, bronchi, or lungs. Evidence: TAS. Frequency: Occasional (HP:0040283). (ORPHA:411703)
- Pleural effusion (HP:0002202): The presence of an excessive amount of fluid in the pleural cavity. Evidence: TAS. Frequency: Occasional (HP:0040283). (ORPHA:411703)
- Lymphadenopathy (HP:0002716): Enlargement (swelling) of a lymph node. Evidence: TAS. Frequency: Occasional (HP:0040283). (ORPHA:411703)
- Chronic pulmonary obstruction (HP:0006510): An anomaly that is characterized progressive airflow obstruction that is only partly reversible, inflammation in the airways, and systemic effects or comorbities. Evidence: TAS. Frequency: Occasional (HP:0040283). (ORPHA:411703)
- Crackles (HP:0030830): Crackles are discontinuous, explosive, and nonmusical adventitious lung sounds normally heard in inspiration and sometimes during expiration. Crackles are usually classified as fine and coarse crackles based on their duration, loudness, pitch, timing in the respiratory cycle, and relationship to coughing and changing body position. Evidence: TAS. Frequency: Occasional (HP:0040283). (ORPHA:411703)
- Mycobacterium abscessus abscessus infection (HP:0032130): Mycobacterium abscessus complex comprises a group of rapidly growing, multidrug-resistant, nontuberculous mycobacteria that are responsible for a wide spectrum of skin and soft tissue diseases, central nervous system infections, bacteremia, and ocular and other infections. Evidence: TAS. Frequency: Occasional (HP:0040283). (ORPHA:411703)
- Disseminated non-tuberculous mycobacterial infection (HP:0032283): Disseminated infection with non-tuberculous mycobacteria (NTM), involving multiple organ systems that occurs in the context of immune deficiency. Evidence: TAS. Frequency: Occasional (HP:0040283). (ORPHA:411703)
- Chest pain (HP:0100749): An unpleasant sensation characterized by physical discomfort (such as pricking, throbbing, or aching) localized to the chest. Evidence: TAS. Frequency: Occasional (HP:0040283). (ORPHA:411703)
- Pneumothorax (HP:0002107): Accumulation of air in the pleural cavity leading to a partially or completely collapsed lung. Evidence: TAS. Frequency: Very rare (HP:0040284). (ORPHA:411703)
These phenotypes are associated with the disease Pulmonary non-tuberculous mycobacterial infection (ORPHA:411703).